- Multiple unerupted teeth (HP:0006283): The presence of multiple embedded tooth germs which have failed to erupt. Evidence: IEA. (OMIM:183300)
- Stillbirth (HP:0003826): Death of the fetus in utero after at least 22 weeks of gestation. Evidence: IEA. (OMIM:183300)
- Crowded maxillary incisors (HP:0006333): A type of dental misalignment with crowded central incisors, i.e., of maxillary secondary incisor, or of maxillary central primary incisor. Evidence: IEA. (OMIM:183300)
- Abnormality of the genitourinary system (HP:0000119): The presence of any abnormality of the genitourinary system. Evidence: IEA. (OMIM:183300)
- Autosomal dominant inheritance (HP:0000006): A mode of inheritance that is observed for traits related to a gene encoded on one of the autosomes (i.e., the human chromosomes 1-22) in which a trait manifests in heterozygotes. In the context of medical genetics, an autosomal dominant disorder is caused when a single copy of the mutant allele is present. Males and females are affected equally, and can both transmit the disorder with a risk of 50% for each child of inheriting the mutant allele. Evidence: IEA. (OMIM:183300)
- Micrognathia (HP:0000347): Developmental hypoplasia of the mandible. Evidence: IEA. (OMIM:183300)
These phenotypes are associated with the disease splenogonadal fusion-limb defects-micrognathia syndrome (OMIM:183300).